Phenotypes associated with the disease Centrifugal lipodystrophy (ORPHA:90156):
- Lipoatrophy (HP:0100578): Localized loss of fat tissue. Evidence: TAS. Frequency: Obligate (HP:0040280). (ORPHA:90156)
- Reduced subcutaneous adipose tissue (HP:0003758): A reduced amount of fat tissue in the lowest layer of the integument. This feature can be appreciated by a reduced skinfold thickness. Evidence: TAS. Frequency: Very frequent (HP:0040281). (ORPHA:90156)
- Absence of subcutaneous fat (HP:0007485): Lack of subcutaneous adipose tissue. Evidence: TAS. Frequency: Frequent (HP:0040282). (ORPHA:90156)
- Abnormal thorax morphology (HP:0000765): Any abnormality of the thorax (the region of the body formed by the sternum, the thoracic vertebrae and the ribs). Evidence: TAS. Frequency: Occasional (HP:0040283). (ORPHA:90156)
- Lymphadenitis (HP:0002840): Inflammation of a lymph node. Evidence: TAS. Frequency: Occasional (HP:0040283). (ORPHA:90156)
- Erythema (HP:0010783): Redness of the skin, caused by hyperemia of the capillaries in the lower layers of the skin. Evidence: TAS. Frequency: Occasional (HP:0040283). (ORPHA:90156)
- Inflammatory abnormality of the skin (HP:0011123): The presence of inflammation of the skin. That is, an abnormality of the skin resulting from the local accumulation of fluid, plasma proteins, and leukocytes. Evidence: TAS. Frequency: Occasional (HP:0040283). (ORPHA:90156)
- Scaling skin (HP:0040189): Refers to the loss of the outer layer of the epidermis in large, scale-like flakes. Evidence: TAS. Frequency: Occasional (HP:0040283). (ORPHA:90156)
- Alopecia (HP:0001596): A noncongenital process of hair loss, which may progress to partial or complete baldness. Evidence: TAS. Frequency: Very rare (HP:0040284). (ORPHA:90156)
- Lack of facial subcutaneous fat (HP:0005320). Evidence: TAS. Frequency: Very rare (HP:0040284). (ORPHA:90156)